- Abnormal palate morphology (HP:0000174): Any abnormality of the palate, i.e., of roof of the mouth. Evidence: TAS. Frequency: Very frequent (HP:0040281). (ORPHA:2291)
- Velopharyngeal insufficiency (HP:0000220): Inability of velopharyngeal sphincter to sufficiently separate the nasal cavity from the oral cavity during speech. Evidence: TAS. Frequency: Very frequent (HP:0040281). (ORPHA:2291)
- Hearing impairment (HP:0000365): A decreased magnitude of the sensory perception of sound. Evidence: TAS. Frequency: Frequent (HP:0040282). (ORPHA:2291)
- Abnormality of the pharynx (HP:0000600): An anomaly of the pharynx, i.e., of the tubular structure extending from the base of the skull superiorly to the esophageal inlet inferiorly. Evidence: TAS. Frequency: Very frequent (HP:0040281). (ORPHA:2291)
- Abnormality of the voice (HP:0001608). Evidence: TAS. Frequency: Very frequent (HP:0040281). (ORPHA:2291)
These phenotypes are associated with the disease Congenital velopharyngeal incompetence (ORPHA:2291).